- Elevated circulating creatine kinase activity (HP:0003236): The activity of creatine kinase in the blood circulation is above the upper limit of normal. Evidence: TAS. (OMIM:609500)
- Myopathy (HP:0003198): A disorder of muscle unrelated to impairment of innervation or neuromuscular junction. Evidence: TAS. (OMIM:609500)
- Hypertrophic cardiomyopathy (HP:0001639): Hypertrophic cardiomyopathy (HCM) is defined by the presence of increased ventricular wall thickness or mass in the absence of loading conditions (hypertension, valve disease) sufficient to cause the observed abnormality. Evidence: TAS. (OMIM:609500)
- Global developmental delay (HP:0001263): A delay in the achievement of motor or mental milestones in the domains of development of a child, including motor skills, speech and language, cognitive skills, and social and emotional skills. This term should only be used to describe children younger than five years of age. Evidence: TAS. (OMIM:609500)
- Autosomal recessive inheritance (HP:0000007): A mode of inheritance that is observed for traits related to a gene encoded on one of the autosomes (i.e., the human chromosomes 1-22) in which a trait manifests in individuals with two pathogenic alleles, either homozygotes (two copies of the same mutant allele) or compound heterozygotes (whereby each copy of a gene has a distinct mutant allele). Evidence: TAS. (OMIM:609500)
- Neonatal hypotonia (HP:0001319): Muscular hypotonia (abnormally low muscle tone) manifesting in the neonatal period. Evidence: TAS. (OMIM:609500)
- Autophagic vacuoles (HP:0003736): The lysosomal-vacuolar pathway has a role in the controlled intracellular digestion of macromolecules such as protein complexes and organelles. This feature refers to the presence of an abnormally increased number of autophagic vacuoles in muscle tissue. Evidence: TAS. (OMIM:609500)
- Sporadic (HP:0003745): Cases of the disease in question occur without a previous family history, i.e., as isolated cases without being transmitted from a parent and without other siblings being affected. Evidence: TAS. (OMIM:609500)
These phenotypes are associated with the disease myopathy, autophagic vacuolar, infantile-onset (OMIM:609500).